- Hypometric saccades (HP:0000571): Saccadic undershoot, i.e., a saccadic eye movement that has less than the magnitude that would be required to gain fixation of the object. Evidence: PCS. Frequency: 1/2. (PMID:22563501)
- Juvenile onset (HP:0003621): Onset of signs or symptoms of disease between the age of 5 and 15 years. Evidence: PCS. Frequency: 2/2. (PMID:22563501)
- Bradykinesia (HP:0002067): Bradykinesia literally means slow movement, and is used clinically to denote a slowness in the execution of movement (in contrast to hypokinesia, which is used to refer to slowness in the initiation of movement). Evidence: PCS. Frequency: 2/2. (PMID:22563501)
- Parkinsonism (HP:0001300): Characteristic neurologic anomaly resulting from degeneration of dopamine-generating cells in the substantia nigra, a region of the midbrain, characterized clinically by shaking, rigidity, slowness of movement and difficulty with walking and gait. Evidence: TAS. (OMIM:615528)
- Dystonia (HP:0001332): An abnormally increased muscular tone that causes fixed abnormal postures. There is a slow, intermittent twisting motion that leads to exaggerated turning and posture of the extremities and trunk. Evidence: TAS. Frequency: Occasional (HP:0040283). (OMIM:615528)
- Seizure (HP:0001250): A seizure is an intermittent abnormality of nervous system physiology characterized by a transient occurrence of signs and/or symptoms due to abnormal excessive or synchronous neuronal activity in the brain. Evidence: TAS. Frequency: Occasional (HP:0040283). (OMIM:615528)
- Shuffling gait (HP:0002362): A type of gait (walking) characterized by by dragging one's feet along or without lifting the feet fully from the ground. Evidence: TAS. (OMIM:615528)
- Dysarthria (HP:0001260): Dysarthric speech is a general description referring to a neurological speech disorder characterized by poor articulation. Depending on the involved neurological structures, dysarthria may be further classified as spastic, flaccid, ataxic, hyperkinetic and hypokinetic, or mixed. Evidence: PCS. Frequency: 2/2. (PMID:22563501)
- Rigidity (HP:0002063): Continuous involuntary sustained muscle contraction. When an affected muscle is passively stretched, the degree of resistance remains constant regardless of the rate at which the muscle is stretched. This feature helps to distinguish rigidity from muscle spasticity. Evidence: PCS. Frequency: 1/2. (PMID:22563501)
- Pill-rolling tremor (HP:0025387): A type of resting tremor characterized by simultaneous rubbing movements of thumb and index fingers against each other. Evidence: PCS. Frequency: 2/2. (PMID:22563501)
- Postural instability (HP:0002172): A tendency to fall or the inability to keep oneself from falling; imbalance. The retropulsion test is widely regarded as the gold standard to evaluate postural instability, Use of the retropulsion test includes a rapid balance perturbation in the backward direction, and the number of balance correcting steps (or total absence thereof) is used to rate the degree of postural instability. Healthy subjects correct such perturbations with either one or two large steps, or without taking any steps, hinging rapidly at the hips while swinging the arms forward as a counterweight. In patients with balance impairment, balance correcting steps are often too small, forcing patients to take more than two steps. Taking three or more steps is generally considered to be abnormal, and taking more than five steps is regarded as being clearly abnormal. Markedly affected patients continue to step backward without ever regaining their balance and must be caught by the examiner (this would be called true retropulsion). Even more severely affected patients fail to correct entirely, and fall backward like a pushed toy soldier, without taking any corrective steps. Evidence: PCS. Frequency: 2/2. (PMID:22563501)
- Glabellar reflex (HP:0030904): A type of primitive reflex that is elicited by repetitive tapping on the forehead. Normal subjects usually blink in response to the first several taps, but if blinking persists, the response is abnormal and considered to be a sign of frontal release. Persistent blinking is also known as Myerson's sign. Evidence: PCS. Frequency: 2/2. (PMID:22563501)
- Cognitive impairment (HP:0100543): Abnormal cognition is characterized by deficits in thinking, reasoning, or remembering. Evidence: TAS. (OMIM:615528)
- Hallucinations (HP:0000738): Perceptions in a conscious and awake state that, in the absence of external stimuli, have qualities of real perception. These perceptions are vivid, substantial, and located in external objective space. Evidence: TAS. (OMIM:615528)
- Limb hypertonia (HP:0002509). Evidence: PCS. Frequency: 2/2. (PMID:22563501)
- Hypomimic face (HP:0000338): A reduced degree of motion of the muscles beneath the skin of the face, often associated with reduced facial crease formation. Evidence: PCS. Frequency: 2/2. (PMID:22563501)
- Abnormal pyramidal sign (HP:0007256): Functional neurological abnormalities related to dysfunction of the pyramidal tract. Evidence: TAS. Frequency: Occasional (HP:0040283). (OMIM:615528)
- Autosomal recessive inheritance (HP:0000007): A mode of inheritance that is observed for traits related to a gene encoded on one of the autosomes (i.e., the human chromosomes 1-22) in which a trait manifests in individuals with two pathogenic alleles, either homozygotes (two copies of the same mutant allele) or compound heterozygotes (whereby each copy of a gene has a distinct mutant allele). Evidence: PCS. (PMID:22563501)
- Loss of ambulation (HP:0002505): Inability to walk in a person who previous had the ability to walk. Evidence: PCS. Frequency: 2/2. (PMID:22563501)
- Spasticity (HP:0001257): A motor disorder characterized by a velocity-dependent increase in tonic stretch reflexes with increased muscle tone, exaggerated (hyperexcitable) tendon reflexes. Evidence: TAS. (OMIM:615528)
- Intellectual disability (HP:0001249): The term intellectual disability or intellectual developmental disorder is used to describe significantly sub-average intellectual and adaptive functioning based on clinical assessment and as measured by individually administered, appropriately normed, standardized and validated tests of intellectual functioning and adaptive behavior, with onset during the developmental period from infancy through adolescence. Evidence: TAS. Frequency: Occasional (HP:0040283). (OMIM:615528)
- Slowly progressive (HP:0003677): Applies to a disease manifestation that only slowly increases in scope or severity over the course of time. Evidence: TAS. (OMIM:615528)
- Rapidly progressive (HP:0003678): Applies to a disease manifestation that quickly increases in scope or severity over the course of time. Evidence: TAS. (OMIM:615528)
These phenotypes are associated with the disease juvenile onset Parkinson disease 19A (OMIM:615528).